- Developmental retinal vascular malformation (HP:0007797): A group of development abnormalities of retinal blood vessels. Evidence: TAS. Frequency: Occasional (HP:0040283). (ORPHA:95429)
- Erythema (HP:0010783): Redness of the skin, caused by hyperemia of the capillaries in the lower layers of the skin. Evidence: TAS. Frequency: Very frequent (HP:0040281). (ORPHA:95429)
- Vascular skin abnormality (HP:0011276). Evidence: TAS. Frequency: Very frequent (HP:0040281). (ORPHA:95429)
- Macule (HP:0012733): A flat, distinct, discolored area of skin less than 1 cm wide that does not involve any change in the thickness or texture of the skin. Evidence: TAS. Frequency: Very frequent (HP:0040281). (ORPHA:95429)
These phenotypes are associated with the disease Angioma serpiginosum (ORPHA:95429).